Phenotypes associated with the disease Tracheal agenesis (ORPHA:3346):
- Polyhydramnios (HP:0001561): The presence of excess amniotic fluid in the uterus during pregnancy. Evidence: TAS. Frequency: Very frequent (HP:0040281). (ORPHA:3346)
- Abnormal cardiac septum morphology (HP:0001671): An anomaly of the intra-atrial or intraventricular septum. Evidence: TAS. Frequency: Very frequent (HP:0040281). (ORPHA:3346)
- Respiratory insufficiency (HP:0002093). Evidence: TAS. Frequency: Very frequent (HP:0040281). (ORPHA:3346)
- Aplasia/Hypoplasia of the lungs (HP:0006703). Evidence: TAS. Frequency: Very frequent (HP:0040281). (ORPHA:3346)
- Tracheal atresia (HP:0100682): A congenital absence or considerable underdevelopment of the trachea such that communication between the larynx proximally and the alveoli of the lungs distally is lacking. Evidence: TAS. Frequency: Very frequent (HP:0040281). (ORPHA:3346)